Phenotypes associated with the disease CODAS syndrome (ORPHA:1458):
- Epicanthus (HP:0000286): A fold of skin starting above the medial aspect of the upper eyelid and arching downward to cover, pass in front of and lateral to the medial canthus. Evidence: TAS. Frequency: Very frequent (HP:0040281). (ORPHA:1458)
- Overfolded helix (HP:0000396): A condition in which the helix is folded over to a greater degree than normal. That is, excessive curling of the helix edge, whereby the free edge is parallel to the plane of the ear. Evidence: TAS. Frequency: Very frequent (HP:0040281). (ORPHA:1458)
- Anteverted nares (HP:0000463): Anteriorly-facing nostrils viewed with the head in the Frankfurt horizontal and the eyes of the observer level with the eyes of the subject. This gives the appearance of an upturned nose (upturned nasal tip). Evidence: TAS. Frequency: Very frequent (HP:0040281). (ORPHA:1458)
- Cataract (HP:0000518): A cataract is an opacity or clouding that develops in the crystalline lens of the eye or in its capsule. Evidence: TAS. Frequency: Very frequent (HP:0040281). (ORPHA:1458)
- Abnormal dental enamel morphology (HP:0000682): An abnormality of the dental enamel. Evidence: TAS. Frequency: Very frequent (HP:0040281). (ORPHA:1458)
- Delayed eruption of teeth (HP:0000684): Delayed tooth eruption, which can be defined as tooth eruption more than 2 SD beyond the mean eruption age. Evidence: TAS. Frequency: Very frequent (HP:0040281). (ORPHA:1458)
- Brachydactyly (HP:0001156): Digits that appear disproportionately short compared to the hand/foot. The word brachydactyly is used here to describe a series distinct patterns of shortened digits (brachydactyly types A-E). This is the sense used here. Evidence: TAS. Frequency: Very frequent (HP:0040281). (ORPHA:1458)
- Global developmental delay (HP:0001263): A delay in the achievement of motor or mental milestones in the domains of development of a child, including motor skills, speech and language, cognitive skills, and social and emotional skills. This term should only be used to describe children younger than five years of age. Evidence: TAS. Frequency: Very frequent (HP:0040281). (ORPHA:1458)
- Delayed skeletal maturation (HP:0002750): A decreased rate of skeletal maturation. Delayed skeletal maturation can be diagnosed on the basis of an estimation of the bone age from radiographs of specific bones in the human body. Evidence: TAS. Frequency: Very frequent (HP:0040281). (ORPHA:1458)
- Short nose (HP:0003196): Distance from nasion to subnasale more than two standard deviations below the mean, or alternatively, an apparently decreased length from the nasal root to the nasal tip. Evidence: TAS. Frequency: Very frequent (HP:0040281). (ORPHA:1458)
- Abnormal vertebral body morphology (HP:0003312): Abnormal form of vertebral body, which is the central cylindrical portion of the vertebra that together with other structures such as the vertebral arch, pedicles, laminae, spinous process, transverse processes, and articular facets makes up a vertebra. Evidence: TAS. Frequency: Very frequent (HP:0040281). (ORPHA:1458)
- Coronal cleft vertebrae (HP:0003417): Frontal schisis (cleft or cleavage) of vertebral bodies. Evidence: TAS. Frequency: Very frequent (HP:0040281). (ORPHA:1458)
- Midline defect of the nose (HP:0004122): This term groups together three conditions that presumably represent different degrees of severity of a midline defect of the nose or nasal tip. Evidence: TAS. Frequency: Very frequent (HP:0040281). (ORPHA:1458)
- Short stature (HP:0004322): A height below that which is expected according to age and gender norms. Although there is no universally accepted definition of short stature, many refer to "short stature" as height more than 2 standard deviations below the mean for age and gender (or below the 3rd percentile for age and gender dependent norms). Evidence: TAS. Frequency: Very frequent (HP:0040281). (ORPHA:1458)
- Depressed nasal bridge (HP:0005280): Posterior positioning of the nasal root in relation to the overall facial profile for age. Evidence: TAS. Frequency: Very frequent (HP:0040281). (ORPHA:1458)
- Abnormal epiphysis morphology (HP:0005930): An anomaly of epiphysis, which is the expanded articular end of a long bone that developes from a secondary ossification center, and which during the period of growth is either entirely cartilaginous or is separated from the shaft by a cartilaginous disk. Evidence: TAS. Frequency: Very frequent (HP:0040281). (ORPHA:1458)
- Abnormal dental morphology (HP:0006482): An abnormality of the morphology of the tooth. Evidence: TAS. Frequency: Very frequent (HP:0040281). (ORPHA:1458)
- Crumpled ear (HP:0009901): Distortion of the course of the normal folds of the ear and the appearance of supernumerary crura and folds. Evidence: TAS. Frequency: Very frequent (HP:0040281). (ORPHA:1458)
- Short metacarpal (HP:0010049): Diminished length of one or more metacarpal bones in relation to the others of the same hand or to the contralateral metacarpal. Evidence: TAS. Frequency: Very frequent (HP:0040281). (ORPHA:1458)
- Flat face (HP:0012368): Absence of concavity or convexity of the face when viewed in profile. Evidence: TAS. Frequency: Very frequent (HP:0040281). (ORPHA:1458)
- Sensorineural hearing impairment (HP:0000407): A type of hearing impairment in one or both ears related to an abnormal functionality of the cochlear nerve. Evidence: TAS. Frequency: Frequent (HP:0040282). (ORPHA:1458)
- Ptosis (HP:0000508): The upper eyelid margin is positioned 3 mm or more lower than usual and covers the superior portion of the iris (objective); or, the upper lid margin obscures at least part of the pupil (subjective). Evidence: TAS. Frequency: Frequent (HP:0040282). (ORPHA:1458)
- Hypotonia (HP:0001252): Hypotonia is an abnormally low muscle tone (the amount of tension or resistance to movement in a muscle). Even when relaxed, muscles have a continuous and passive partial contraction which provides some resistance to passive stretching. Hypotonia thus manifests as diminished resistance to passive stretching. Hypotonia is not the same as muscle weakness, although the two conditions can co-exist. Evidence: TAS. Frequency: Frequent (HP:0040282). (ORPHA:1458)
- Congenital hip dislocation (HP:0001374). Evidence: TAS. Frequency: Frequent (HP:0040282). (ORPHA:1458)
- Abnormal pelvic girdle bone morphology (HP:0002644): An abnormality of the bony pelvic girdle, which is a ring of bones connecting the vertebral column to the femurs. Evidence: TAS. Frequency: Frequent (HP:0040282). (ORPHA:1458)
- Scoliosis (HP:0002650): The presence of an abnormal lateral curvature of the spine. Evidence: TAS. Frequency: Frequent (HP:0040282). (ORPHA:1458)
- Hydroureter (HP:0000072): The distention of the ureter with urine. Evidence: TAS. Frequency: Occasional (HP:0040283). (ORPHA:1458)
- Strabismus (HP:0000486): A misalignment of the eyes so that the visual axes deviate from bifoveal fixation. The classification of strabismus may be based on a number of features including the relative position of the eyes, whether the deviation is latent or manifest, intermittent or constant, concomitant or otherwise and according to the age of onset and the relevance of any associated refractive error. Evidence: TAS. Frequency: Occasional (HP:0040283). (ORPHA:1458)
- Nystagmus (HP:0000639): Rhythmic, involuntary oscillations of one or both eyes related to abnormality in fixation, conjugate gaze, or vestibular mechanisms. Evidence: TAS. Frequency: Occasional (HP:0040283). (ORPHA:1458)
- Abnormality of the larynx (HP:0001600): An abnormality of the larynx. Evidence: TAS. Frequency: Occasional (HP:0040283). (ORPHA:1458)
- Ventricular septal defect (HP:0001629): A hole between the two bottom chambers (ventricles) of the heart. The defect is centered around the most superior aspect of the ventricular septum. Evidence: TAS. Frequency: Occasional (HP:0040283). (ORPHA:1458)
- Extrahepatic biliary duct atresia (HP:0005242): Atresia in the extrahepatic bile duct. Evidence: TAS. Frequency: Occasional (HP:0040283). (ORPHA:1458)
- Joint hypermobility (HP:0001382): The capability that a joint (or a group of joints) has to move, passively and/or actively, beyond normal limits along physiological axes. Evidence: TAS. Frequency: Frequent (HP:0040282). (ORPHA:1458)